Phenotypes associated with the disease Non-eruption of teeth-maxillary hypoplasia-genu valgum syndrome (ORPHA:2972):
- Malar flattening (HP:0000272): Underdevelopment of the malar prominence of the jugal bone (zygomatic bone in mammals), appreciated in profile, frontal view, and/or by palpation. Evidence: TAS. Frequency: Very frequent (HP:0040281). (ORPHA:2972)
- Hypodontia (HP:0000668): The absence of five or less teeth from the normal series by a failure to develop. Evidence: TAS. Frequency: Very frequent (HP:0040281). (ORPHA:2972)
- Delayed eruption of teeth (HP:0000684): Delayed tooth eruption, which can be defined as tooth eruption more than 2 SD beyond the mean eruption age. Evidence: TAS. Frequency: Very frequent (HP:0040281). (ORPHA:2972)
- Genu valgum (HP:0002857): The legs angle inward, such that the knees are close together and the ankles far apart. Evidence: TAS. Frequency: Very frequent (HP:0040281). (ORPHA:2972)
- Maxillozygomatic hypoplasia (HP:0005439): Hypoplasia of the maxillozygomatic complex. Evidence: TAS. Frequency: Very frequent (HP:0040281). (ORPHA:2972)
- Alveolar process hypoplasia (HP:0006329): Underdevelopment of the alveolar process (also known as alveolar bone). Evidence: TAS. Frequency: Very frequent (HP:0040281). (ORPHA:2972)
- Abnormal dental morphology (HP:0006482): An abnormality of the morphology of the tooth. Evidence: TAS. Frequency: Very frequent (HP:0040281). (ORPHA:2972)
- Posteriorly rotated ears (HP:0000358): A type of abnormal location of the ears in which the position of the ears is characterized by posterior rotation (the superior part of the ears is rotated towards the back of the head, and the inferior part of the ears towards the front). Evidence: TAS. Frequency: Frequent (HP:0040282). (ORPHA:2972)